- Adrenal hypoplasia (HP:0000835): Developmental hypoplasia of the adrenal glands. Evidence: TAS. Frequency: Frequent (HP:0040282). (ORPHA:563609)
- Intrauterine growth retardation (HP:0001511): An abnormal restriction of fetal growth with fetal weight below the tenth percentile for gestational age. Evidence: TAS. Frequency: Frequent (HP:0040282). (ORPHA:563609)
- Congenital diaphragmatic hernia (HP:0000776): The presence of a hernia of the diaphragm present at birth. Evidence: TAS. Frequency: Occasional (HP:0040283). (ORPHA:563609)
- Omphalocele (HP:0001539): A midline anterior incomplete closure of the abdominal wall in which there is herniation of the abdominal viscera into the base of the abdominal cord. Evidence: TAS. Frequency: Occasional (HP:0040283). (ORPHA:563609)
- Maternal diabetes (HP:0009800): Maternal diabetes can either be a gestational, mostly type 2 diabetes, or a type 1 diabetes. Essential is the resulting maternal hyperglycemia as a non-specific teratogen, imposing the same risk of congenital malformations to pregnant women with both type 1 and type2 diabetes. Evidence: TAS. Frequency: Occasional (HP:0040283). (ORPHA:563609)
- Thymus hyperplasia (HP:0010516): Enlargement of the thymus. Evidence: TAS. Frequency: Occasional (HP:0040283). (ORPHA:563609)
- Maternal fever in pregnancy (HP:0030244): The occurrence of an elevated body temperature of the mother during pregnancy. Evidence: TAS. Frequency: Occasional (HP:0040283). (ORPHA:563609)
- Cleft lip (HP:0410030): A gap in the lip or lips. Evidence: TAS. Frequency: Occasional (HP:0040283). (ORPHA:563609)
These phenotypes are associated with the disease Isolated anencephaly (ORPHA:563609).